- Abnormality of the nervous system (HP:0000707): An abnormality of the nervous system. Evidence: IEA. (OMIM:257000)
- Abnormality of metabolism/homeostasis (HP:0001939). Evidence: IEA. (OMIM:257000)
- Autosomal recessive inheritance (HP:0000007): A mode of inheritance that is observed for traits related to a gene encoded on one of the autosomes (i.e., the human chromosomes 1-22) in which a trait manifests in individuals with two pathogenic alleles, either homozygotes (two copies of the same mutant allele) or compound heterozygotes (whereby each copy of a gene has a distinct mutant allele). Evidence: IEA. (OMIM:257000)
These phenotypes are associated with the disease NEUROVISCERAL STORAGE DISEASE WITH CURVILINEAR BODIES (OMIM:257000).